Phenotypes associated with the disease Marie Unna hereditary hypotrichosis (ORPHA:444):
- Alopecia (HP:0001596): A noncongenital process of hair loss, which may progress to partial or complete baldness. Evidence: TAS. Frequency: Very frequent (HP:0040281). (ORPHA:444)
- Coarse hair (HP:0002208): Hair shafts are rough in texture. Evidence: TAS. Frequency: Very frequent (HP:0040281). (ORPHA:444)
- Sparse scalp hair (HP:0002209): Decreased number of hairs per unit area of skin of the scalp. Evidence: TAS. Frequency: Very frequent (HP:0040281). (ORPHA:444)
- Aplasia/Hypoplasia of the eyebrow (HP:0100840): Absence or underdevelopment of the eyebrow. Evidence: TAS. Frequency: Very frequent (HP:0040281). (ORPHA:444)
- Sparse or absent eyelashes (HP:0200102). Evidence: TAS. Frequency: Very frequent (HP:0040281). (ORPHA:444)